- Dilated cardiomyopathy (HP:0001644): Dilated cardiomyopathy (DCM) is defined by the presence of left ventricular dilatation and left ventricular systolic dysfunction in the absence of abnormal loading conditions (hypertension, valve disease) or coronary artery disease sufficient to cause global systolic impairment. Right ventricular dilation and dysfunction may be present but are not necessary for the diagnosis. Evidence: TAS. Frequency: Very frequent (HP:0040281). (ORPHA:91131)
- Type I transferrin isoform profile (HP:0003642): Abnormal transferrin isoform profile consistent with a type I congenital disorder of glycosylation. In the traditional nomenclature for congenital disorders of glycosylation, absence of entire glycans was designated type I, and loss of one or more monosaccharides as type II. Evidence: TAS. Frequency: Very frequent (HP:0040281). (ORPHA:91131)
- Abnormal circulating enzyme concentration or activity (HP:0012379): Concentration or activity of an enzyme is above or below the limits of normal in the blood circulation. Evidence: TAS. Frequency: Very frequent (HP:0040281). (ORPHA:91131)
- Cardiomyocyte hypertrophy (HP:0031319): An increase in cell size, enhanced protein synthesis, and heightened organization of the sarcomere within cardiac myocytes. Evidence: TAS. Frequency: Very frequent (HP:0040281). (ORPHA:91131)
- Seizure (HP:0001250): A seizure is an intermittent abnormality of nervous system physiology characterized by a transient occurrence of signs and/or symptoms due to abnormal excessive or synchronous neuronal activity in the brain. Evidence: TAS. Frequency: Frequent (HP:0040282). (ORPHA:91131)
- Failure to thrive (HP:0001508): Failure to thrive (FTT) refers to a child whose physical growth is substantially below the norm. Evidence: TAS. Frequency: Frequent (HP:0040282). (ORPHA:91131)
- Congestive heart failure (HP:0001635): The presence of an abnormality of cardiac function that is responsible for the failure of the heart to pump blood at a rate that is commensurate with the needs of the tissues or a state in which abnormally elevated filling pressures are required for the heart to do so. Heart failure is frequently related to a defect in myocardial contraction. Evidence: TAS. Frequency: Frequent (HP:0040282). (ORPHA:91131)
- Elevated circulating hepatic transaminase concentration (HP:0002910): Elevations of the levels of SGOT and SGPT in the serum. SGOT (serum glutamic oxaloacetic transaminase) and SGPT (serum glutamic pyruvic transaminase) are transaminases primarily found in the liver and heart and are released into the bloodstream as the result of liver or heart damage. SGOT and SGPT are used clinically mainly as markers of liver damage. Evidence: TAS. Frequency: Frequent (HP:0040282). (ORPHA:91131)
- Ichthyosis (HP:0008064): An abnormality of the skin characterized the presence of excessive amounts of dry surface scales on the skin resulting from an abnormality of keratinization. Evidence: TAS. Frequency: Frequent (HP:0040282). (ORPHA:91131)
- Mild global developmental delay (HP:0011342): A mild delay in the achievement of motor or mental milestones in the domains of development of a child. Evidence: TAS. Frequency: Frequent (HP:0040282). (ORPHA:91131)
- Interstitial cardiac fibrosis (HP:0031329): A type of myocardial fibrosis characterized by excessive diffuse collagen accumulation concentrated in interstitial spaces. Evidence: TAS. Frequency: Frequent (HP:0040282). (ORPHA:91131)
- Progressive microcephaly (HP:0000253): Progressive microcephaly is diagnosed when the head circumference falls progressively behind age- and gender-dependent norms. Evidence: TAS. Frequency: Occasional (HP:0040283). (ORPHA:91131)
- Strabismus (HP:0000486): A misalignment of the eyes so that the visual axes deviate from bifoveal fixation. The classification of strabismus may be based on a number of features including the relative position of the eyes, whether the deviation is latent or manifest, intermittent or constant, concomitant or otherwise and according to the age of onset and the relevance of any associated refractive error. Evidence: TAS. Frequency: Occasional (HP:0040283). (ORPHA:91131)
- Visual impairment (HP:0000505): Visual impairment (or vision impairment) is vision loss (of a person) to such a degree as to qualify as an additional support need through a significant limitation of visual capability resulting from either disease, trauma, or congenital or degenerative conditions that cannot be corrected by conventional means, such as refractive correction, medication, or surgery. Evidence: TAS. Frequency: Occasional (HP:0040283). (ORPHA:91131)
- Autistic behavior (HP:0000729): Persistent deficits in social interaction and communication and interaction as well as a markedly restricted repertoire of activity and interest as well as repetitive patterns of behavior. Evidence: TAS. Frequency: Occasional (HP:0040283). (ORPHA:91131)
- Reduced eye contact (HP:0000817): A reduced frequency or duration of eye contact. Evidence: TAS. Frequency: Occasional (HP:0040283). (ORPHA:91131)
- Intellectual disability (HP:0001249): The term intellectual disability or intellectual developmental disorder is used to describe significantly sub-average intellectual and adaptive functioning based on clinical assessment and as measured by individually administered, appropriately normed, standardized and validated tests of intellectual functioning and adaptive behavior, with onset during the developmental period from infancy through adolescence. Evidence: TAS. Frequency: Occasional (HP:0040283). (ORPHA:91131)
- Motor delay (HP:0001270): A type of Developmental delay characterized by a delay in acquiring motor skills. Evidence: TAS. Frequency: Occasional (HP:0040283). (ORPHA:91131)
- Absent speech (HP:0001344): Complete lack of development of speech and language abilities. Evidence: TAS. Frequency: Occasional (HP:0040283). (ORPHA:91131)
- Bilateral tonic-clonic seizure (HP:0002069): A bilateral tonic-clonic seizure is a seizure defined by a tonic (bilateral increased tone, lasting seconds to minutes) and then a clonic (bilateral sustained rhythmic jerking) phase. Evidence: TAS. Frequency: Occasional (HP:0040283). (ORPHA:91131)
- Hypsarrhythmia (HP:0002521): Hypsarrhythmia is abnormal interictal high amplitude waves and a background of irregular spikes. There is continuous (during wakefulness), high-amplitude (>200 Hz), generalized polymorphic slowing with no organized background and multifocal spikes demonstrated by electroencephalography (EEG). Evidence: TAS. Frequency: Occasional (HP:0040283). (ORPHA:91131)
- Progressive muscle weakness (HP:0003323). Evidence: TAS. Frequency: Occasional (HP:0040283). (ORPHA:91131)
- Short stature (HP:0004322): A height below that which is expected according to age and gender norms. Although there is no universally accepted definition of short stature, many refer to "short stature" as height more than 2 standard deviations below the mean for age and gender (or below the 3rd percentile for age and gender dependent norms). Evidence: TAS. Frequency: Occasional (HP:0040283). (ORPHA:91131)
- Severe muscular hypotonia (HP:0006829): A severe degree of muscular hypotonia characterized by markedly reduced muscle tone. Evidence: TAS. Frequency: Occasional (HP:0040283). (ORPHA:91131)
- Focal-onset seizure (HP:0007359): A focal-onset seizure is a type of seizure originating within networks limited to one hemisphere. They may be discretely localized or more widely distributed, and may originate in subcortical structures. Evidence: TAS. Frequency: Occasional (HP:0040283). (ORPHA:91131)
- Floppy infant (HP:0008947): Floppiness/hypotonia is defined as reduced resistance to passive movement of joints. Physical examination of floppy/hypotonic infants shows head lag, lack of shoulder and elbow muscle contraction on traction response, inability to tighten the shoulder girdle muscles (or slipping through) when held under the axillae, scarf sign (when the arm is pulled to the opposite side, the arm wraps around the neck with the elbow crossing midline), hyperdorsiflexion of the feet, easy apposition of the thumb against the forearm, feet touching the cheek with ease and without discomfort, frog leg position, and inverted U sign on ventral suspension (head, arms, and legs hanging down without elbow or knee flexion and the trunk rounded in a dome shape). Evidence: TAS. Frequency: Occasional (HP:0040283). (ORPHA:91131)
- Multifocal epileptiform discharges (HP:0010841): An abnormality in cerebral electrical activity recorded along the scalp by electroencephalography (EEG) and being identified at multiple locations (foci). Evidence: TAS. Frequency: Occasional (HP:0040283). (ORPHA:91131)
- EEG with generalized slow activity (HP:0010845): Diffuse slowing of cerebral electrical activity recorded along the scalp by electroencephalography (EEG). Evidence: TAS. Frequency: Occasional (HP:0040283). (ORPHA:91131)
- Arrhythmia (HP:0011675): Any cardiac rhythm other than the normal sinus rhythm. Such a rhythm may be either of sinus or ectopic origin and either regular or irregular. An arrhythmia may be due to a disturbance in impulse formation or conduction or both. Evidence: TAS. Frequency: Occasional (HP:0040283). (ORPHA:91131)
- Infantile spasms (HP:0012469): Infantile spasms represent a subset of "epileptic spasms". Infantile Spasms are epileptic spasms starting in the first year of life (infancy). Evidence: TAS. Frequency: Occasional (HP:0040283). (ORPHA:91131)
- Delayed ability to stand (HP:0025335): A failure to achieve the ability to stand up at an appropriate developmental stage. Most children begin to walk alone at 11 to 15 months of age. On average, children can stand while holding on at the age of 9 to 10 months, can pull up to stand and walk with one hand being held at 12 months, and can stand alone and walk well at 18 months. Evidence: TAS. Frequency: Occasional (HP:0040283). (ORPHA:91131)
- Delayed ability to walk (HP:0031936): A failure to achieve the ability to walk at an appropriate developmental stage. Most children learn to walk in a series of stages, and learn to walk short distances independently between 12 and 15 months. Evidence: TAS. Frequency: Occasional (HP:0040283). (ORPHA:91131)
These phenotypes are associated with the disease DK1-CDG (ORPHA:91131).